Phenotypes associated with the disease goiter, multinodular 2 (OMIM:300273):
- Euthyroid multinodular goiter (HP:0000866). Evidence: IEA. (OMIM:300273)
- X-linked dominant inheritance (HP:0001423): A mode of inheritance that is observed for dominant traits related to a gene encoded on the X chromosome. In the context of medical genetics, X-linked dominant disorders tend to manifest very severely in affected males. The severity of manifestation in females may depend on the degree of skewed X inactivation. Evidence: IEA. (OMIM:300273)